- Abnormality of the respiratory system (HP:0002086): An abnormality of the respiratory system, which include the airways, lungs, and the respiratory muscles. Evidence: IEA. (OMIM:235500)
- Autosomal recessive inheritance (HP:0000007): A mode of inheritance that is observed for traits related to a gene encoded on one of the autosomes (i.e., the human chromosomes 1-22) in which a trait manifests in individuals with two pathogenic alleles, either homozygotes (two copies of the same mutant allele) or compound heterozygotes (whereby each copy of a gene has a distinct mutant allele). Evidence: IEA. (OMIM:235500)
- Decreased circulating IgA concentration (HP:0002720): Decreased levels of immunoglobulin A (IgA). Evidence: IEA. (OMIM:235500)
These phenotypes are associated with the disease hemosiderosis, pulmonary, with deficiency of gamma-a globulin (OMIM:235500).